Phenotypes associated with the disease DERMATOGLYPHICS--PALMAR TRIRADIUS D, ABSENCE OF (OMIM:221760):
- Autosomal recessive inheritance (HP:0000007): A mode of inheritance that is observed for traits related to a gene encoded on one of the autosomes (i.e., the human chromosomes 1-22) in which a trait manifests in individuals with two pathogenic alleles, either homozygotes (two copies of the same mutant allele) or compound heterozygotes (whereby each copy of a gene has a distinct mutant allele). Evidence: IEA. (OMIM:221760)
- Abnormal dermatoglyphics (HP:0007477): An abnormality of dermatoglyphs (fingerprints), which are present on fingers, palms, toes, and soles. Evidence: IEA. (OMIM:221760)